- Abnormal nail morphology (HP:0001597): Abnormal structure or appearance of the nail. Evidence: IEA. (OMIM:189150)
- Autosomal dominant inheritance (HP:0000006): A mode of inheritance that is observed for traits related to a gene encoded on one of the autosomes (i.e., the human chromosomes 1-22) in which a trait manifests in heterozygotes. In the context of medical genetics, an autosomal dominant disorder is caused when a single copy of the mutant allele is present. Males and females are affected equally, and can both transmit the disorder with a risk of 50% for each child of inheriting the mutant allele. Evidence: IEA. (OMIM:189150)
These phenotypes are associated with the disease toe, rotated fifth (OMIM:189150).